Phenotypes associated with the disease hyperproinsulinemia (OMIM:616214):
- Hyperglycemia (HP:0003074): An increased concentration of glucose in the blood. Evidence: TAS. Frequency: Occasional (HP:0040283). (OMIM:616214)
- Hyperinsulinemia (HP:0000842): An increased concentration of insulin in the blood. Evidence: TAS. Frequency: Occasional (HP:0040283). (OMIM:616214)
- Autosomal dominant inheritance (HP:0000006): A mode of inheritance that is observed for traits related to a gene encoded on one of the autosomes (i.e., the human chromosomes 1-22) in which a trait manifests in heterozygotes. In the context of medical genetics, an autosomal dominant disorder is caused when a single copy of the mutant allele is present. Males and females are affected equally, and can both transmit the disorder with a risk of 50% for each child of inheriting the mutant allele. Evidence: PCS. (PMID:3470784)